- Neoplasm (HP:0002664): An organ or organ-system abnormality that consists of uncontrolled autonomous cell-proliferation which can occur in any part of the body as a benign or malignant neoplasm (tumor). Evidence: IEA. (OMIM:114450)
- Autosomal dominant inheritance (HP:0000006): A mode of inheritance that is observed for traits related to a gene encoded on one of the autosomes (i.e., the human chromosomes 1-22) in which a trait manifests in heterozygotes. In the context of medical genetics, an autosomal dominant disorder is caused when a single copy of the mutant allele is present. Males and females are affected equally, and can both transmit the disorder with a risk of 50% for each child of inheriting the mutant allele. Evidence: IEA. (OMIM:114450)
These phenotypes are associated with the disease cancer, familial, with in vitro Radioresistance (OMIM:114450).